- Micropenis (HP:0000054): Abnormally small penis. At birth, the normal penis is about 3 cm (stretched length from pubic tubercle to tip of penis) with micropenis less than 2.0-2.5 cm. Evidence: TAS. Frequency: Obligate (HP:0040280). (ORPHA:95707)
This phenotype is associated with the disease Idiopathic isolated micropenis (ORPHA:95707).
The following phenotypes are NOT associated with this disease:
- Hypospadias (HP:0000047): Abnormal position of urethral meatus on the ventral penile shaft (underside) characterized by displacement of the urethral meatus from the tip of the glans penis to the ventral surface of the penis, scrotum, or perineum. Evidence: TAS. (ORPHA:95707)
- Ambiguous genitalia (HP:0000062): A genital phenotype that is not clearly assignable to a single gender. Ambiguous genitalia can be evaluated using the Prader scale: Prader 0: Normal female external genitalia. Prader 1: Female external genitalia with clitoromegaly. Prader 2: Clitoromegaly with partial labial fusion forming a funnel-shaped urogenital sinus. Prader 3: Increased phallic enlargement. Complete labioscrotal fusion forming a urogenital sinus with a single opening. Prader 4: Complete scrotal fusion with urogenital opening at the base or on the shaft of the phallus. Prader 5: Normal male external genitalia. The diagnosis of ambiguous genitalia is made for Prader 1-4. Evidence: TAS. (ORPHA:95707)